Phenotypes associated with the disease Hydrocephalus-costovertebral dysplasia-Sprengel anomaly syndrome (ORPHA:2180):
- Hydrocephalus (HP:0000238): Hydrocephalus is an active distension of the ventricular system of the brain resulting from inadequate passage of CSF from its point of production within the cerebral ventricles to its point of absorption into the systemic circulation. Evidence: TAS. Frequency: Very frequent (HP:0040281). (ORPHA:2180)
- Mandibular prognathia (HP:0000303): Abnormal prominence of the chin related to increased length of the mandible. Evidence: TAS. Frequency: Very frequent (HP:0040281). (ORPHA:2180)
- Sprengel anomaly (HP:0000912): A congenital skeletal deformity characterized by the elevation of one scapula (thus, one scapula is located superior to the other). Evidence: TAS. Frequency: Very frequent (HP:0040281). (ORPHA:2180)
- High palate (HP:0000218): Height of the palate more than 2 SD above the mean (objective) or palatal height at the level of the first permanent molar more than twice the height of the teeth (subjective). Evidence: TAS. Frequency: Frequent (HP:0040282). (ORPHA:2180)
- Macrocephaly (HP:0000256): Occipitofrontal (head) circumference greater than 97th centile compared to appropriate, age matched, sex-matched normal standards. Alternatively, a apparently increased size of the cranium. Evidence: TAS. Frequency: Frequent (HP:0040282). (ORPHA:2180)
- Malar flattening (HP:0000272): Underdevelopment of the malar prominence of the jugal bone (zygomatic bone in mammals), appreciated in profile, frontal view, and/or by palpation. Evidence: TAS. Frequency: Frequent (HP:0040282). (ORPHA:2180)
- Hypertelorism (HP:0000316): Interpupillary distance more than 2 SD above the mean (alternatively, the appearance of an increased interpupillary distance or widely spaced eyes). Evidence: TAS. Frequency: Frequent (HP:0040282). (ORPHA:2180)
- High forehead (HP:0000348): An abnormally increased height of the forehead. Evidence: TAS. Frequency: Frequent (HP:0040282). (ORPHA:2180)
- Low-set ears (HP:0000369): Upper insertion of the ear to the scalp below an imaginary horizontal line drawn between the inner canthi of the eye and extending posteriorly to the ear. Evidence: TAS. Frequency: Frequent (HP:0040282). (ORPHA:2180)
- Bulbous nose (HP:0000414): Increased volume and globular shape of the anteroinferior aspect of the nose. Evidence: TAS. Frequency: Frequent (HP:0040282). (ORPHA:2180)
- Wide nasal bridge (HP:0000431): Increased breadth of the nasal bridge (and with it, the nasal root). Evidence: TAS. Frequency: Frequent (HP:0040282). (ORPHA:2180)
- Prominent nose (HP:0000448): Distance between subnasale and pronasale more than two standard deviations above the mean, or alternatively, an apparently increased anterior protrusion of the nasal tip. Evidence: TAS. Frequency: Frequent (HP:0040282). (ORPHA:2180)
- Anteverted nares (HP:0000463): Anteriorly-facing nostrils viewed with the head in the Frankfurt horizontal and the eyes of the observer level with the eyes of the subject. This gives the appearance of an upturned nose (upturned nasal tip). Evidence: TAS. Frequency: Frequent (HP:0040282). (ORPHA:2180)
- Abnormal dental enamel morphology (HP:0000682): An abnormality of the dental enamel. Evidence: TAS. Frequency: Frequent (HP:0040282). (ORPHA:2180)
- Atypical behavior (HP:0000708): Atypical behavior is an abnormality in a person's actions that can be controlled or modulated by the will of the individual. While abnormal behaviors can be difficult to control, they are distinct from other abnormal actions that cannot be affected by the individual's will. Evidence: TAS. Frequency: Frequent (HP:0040282). (ORPHA:2180)
- Abnormal rib morphology (HP:0000772): An anomaly of the rib. Evidence: TAS. Frequency: Frequent (HP:0040282). (ORPHA:2180)
- Cutaneous photosensitivity (HP:0000992): An increased sensitivity of the skin to light. Photosensitivity may result in a rash upon exposure to the sun (which is known as photodermatosis). Photosensitivity can be diagnosed by phototests in which light is shone on small areas of skin. Evidence: TAS. Frequency: Frequent (HP:0040282). (ORPHA:2180)
- Abnormal skin pigmentation (HP:0001000): An abnormality of the pigmentation of the skin. Evidence: TAS. Frequency: Frequent (HP:0040282). (ORPHA:2180)
- Brachydactyly (HP:0001156): Digits that appear disproportionately short compared to the hand/foot. The word brachydactyly is used here to describe a series distinct patterns of shortened digits (brachydactyly types A-E). This is the sense used here. Evidence: TAS. Frequency: Frequent (HP:0040282). (ORPHA:2180)
- Intellectual disability (HP:0001249): The term intellectual disability or intellectual developmental disorder is used to describe significantly sub-average intellectual and adaptive functioning based on clinical assessment and as measured by individually administered, appropriately normed, standardized and validated tests of intellectual functioning and adaptive behavior, with onset during the developmental period from infancy through adolescence. Evidence: TAS. Frequency: Frequent (HP:0040282). (ORPHA:2180)
- Obesity (HP:0001513): Accumulation of substantial excess body fat. Evidence: TAS. Frequency: Frequent (HP:0040282). (ORPHA:2180)
- Sandal gap (HP:0001852): A widely spaced gap between the first toe (the great toe) and the second toe. Evidence: TAS. Frequency: Frequent (HP:0040282). (ORPHA:2180)
- Scoliosis (HP:0002650): The presence of an abnormal lateral curvature of the spine. Evidence: TAS. Frequency: Frequent (HP:0040282). (ORPHA:2180)
- Hemivertebrae (HP:0002937): Absence of one half of the vertebral body. Evidence: TAS. Frequency: Frequent (HP:0040282). (ORPHA:2180)
- Abnormal vertebral body morphology (HP:0003312): Abnormal form of vertebral body, which is the central cylindrical portion of the vertebra that together with other structures such as the vertebral arch, pedicles, laminae, spinous process, transverse processes, and articular facets makes up a vertebra. Evidence: TAS. Frequency: Frequent (HP:0040282). (ORPHA:2180)
- Depressed nasal bridge (HP:0005280): Posterior positioning of the nasal root in relation to the overall facial profile for age. Evidence: TAS. Frequency: Frequent (HP:0040282). (ORPHA:2180)
- Strabismus (HP:0000486): A misalignment of the eyes so that the visual axes deviate from bifoveal fixation. The classification of strabismus may be based on a number of features including the relative position of the eyes, whether the deviation is latent or manifest, intermittent or constant, concomitant or otherwise and according to the age of onset and the relevance of any associated refractive error. Evidence: TAS. Frequency: Occasional (HP:0040283). (ORPHA:2180)
- Myopia (HP:0000545): An abnormality of refraction characterized by the ability to see objects nearby clearly, while objects in the distance appear blurry. Evidence: TAS. Frequency: Occasional (HP:0040283). (ORPHA:2180)
- Wide intermamillary distance (HP:0006610): A larger than usual distance between the left and right nipple. Evidence: TAS. Frequency: Occasional (HP:0040283). (ORPHA:2180)